Phenotypes associated with the disease MPDU1-congenital disorder of glycosylation (OMIM:609180):
- Hypertonia (HP:0001276): A condition in which there is increased muscle tone so that arms or legs, for example, are stiff and difficult to move. Evidence: PCS. Frequency: 1/3. (PMID:11733564)
- Parietal bossing (HP:0000242): Parietal bossing is a marked prominence in the parietal region. Evidence: PCS. Frequency: 1/3. (PMID:11733564)
- Hypsarrhythmia (HP:0002521): Hypsarrhythmia is abnormal interictal high amplitude waves and a background of irregular spikes. There is continuous (during wakefulness), high-amplitude (>200 Hz), generalized polymorphic slowing with no organized background and multifocal spikes demonstrated by electroencephalography (EEG). Evidence: PCS. Frequency: 1/3. (PMID:11733564)
- Strabismus (HP:0000486): A misalignment of the eyes so that the visual axes deviate from bifoveal fixation. The classification of strabismus may be based on a number of features including the relative position of the eyes, whether the deviation is latent or manifest, intermittent or constant, concomitant or otherwise and according to the age of onset and the relevance of any associated refractive error. Evidence: TAS. (OMIM:609180)
- Abnormality of the coagulation cascade (HP:0003256): An abnormality of the coagulation cascade, which is comprised of the contact activation pathway (also known as the intrinsic pathway) and the tissue factor pathway (also known as the extrinsic pathway) as well as cofactors and regulators. Evidence: TAS. Frequency: Occasional (HP:0040283). (OMIM:609180)
- Flexion contracture (HP:0001371): A flexion contracture is a bent (flexed) joint that cannot be straightened actively or passively. It is thus a chronic loss of joint motion due to structural changes in muscle, tendons, ligaments, or skin that prevents normal movement of joints. Evidence: TAS. (OMIM:609180)
- Seizure (HP:0001250): A seizure is an intermittent abnormality of nervous system physiology characterized by a transient occurrence of signs and/or symptoms due to abnormal excessive or synchronous neuronal activity in the brain. Evidence: PCS. Frequency: 3/3. (PMID:11733564)
- Wide anterior fontanel (HP:0000260): Enlargement of the anterior fontanelle with respect to age-dependent norms. Evidence: PCS. Frequency: 1/3. (PMID:11733564)
- Hypotonia (HP:0001252): Hypotonia is an abnormally low muscle tone (the amount of tension or resistance to movement in a muscle). Even when relaxed, muscles have a continuous and passive partial contraction which provides some resistance to passive stretching. Hypotonia thus manifests as diminished resistance to passive stretching. Hypotonia is not the same as muscle weakness, although the two conditions can co-exist. Evidence: PCS. Frequency: 2/3. (PMID:11733564)
- Ataxia (HP:0001251): Ataxia refers to impaired coordination of voluntary muscle movement. Cerebellar ataxia refers to ataxia due to dysfunction of the cerebellum. This causes a variety of elementary neurological deficits including asynergy (lack of coordination between muscles, limbs and joints), dysmetria (lack of ability to judge distances that can lead to under- or overshoot in grasping movements), and dysdiadochokinesia (inability to perform rapid movements requiring antagonizing muscle groups to be switched on and off repeatedly). Evidence: TAS. (OMIM:609180)
- Infantile onset (HP:0003593): Onset of signs or symptoms of disease between 28 days to one year of life. Evidence: PCS. Frequency: 1/3. (PMID:11733564)
- Dry skin (HP:0000958): Skin characterized by the lack of natural or normal moisture. Evidence: TAS. (OMIM:609180)
- Failure to thrive (HP:0001508): Failure to thrive (FTT) refers to a child whose physical growth is substantially below the norm. Evidence: TAS. (OMIM:609180)
- Nystagmus (HP:0000639): Rhythmic, involuntary oscillations of one or both eyes related to abnormality in fixation, conjugate gaze, or vestibular mechanisms. Evidence: TAS. (OMIM:609180)
- Ventriculomegaly (HP:0002119): An increase in size of the ventricular system of the brain. Evidence: PCS. Frequency: 1/3. (PMID:11733564)
- Death in infancy (HP:0001522): Death within the first 24 months of life. Evidence: PCS. Frequency: 1/3. (PMID:11733564)
- Neonatal onset (HP:0003623): Onset of signs or symptoms of disease within the first 28 days of life. Evidence: PCS. Frequency: 2/3. (PMID:11733564)
- Cerebral atrophy (HP:0002059): Atrophy (wasting, decrease in size of cells or tissue) affecting the cerebrum. Evidence: TAS. (OMIM:609180)
- Microcephaly (HP:0000252): Head circumference below 2 standard deviations below the mean for age and gender. Evidence: TAS. (OMIM:609180)
- Absent speech (HP:0001344): Complete lack of development of speech and language abilities. Evidence: TAS. (OMIM:609180)
- Thin vermilion border (HP:0000233): Height of the vermilion of the medial part of the lip more than 2 SD below the mean, or apparently reduced height of the vermilion of the lip in the frontal view. The vermilion is the red part of the lips (and confusingly, the vermilion itself is also often referred to as being equivalent the lips). Evidence: PCS. Frequency: 1/3. (PMID:11733564)
- Feeding difficulties (HP:0011968): Impaired ability to eat related to problems gathering food and getting ready to suck, chew, or swallow it. Evidence: PCS. Frequency: 1/3. (PMID:11733564)
- Severe global developmental delay (HP:0011344): A severe delay in the achievement of motor or mental milestones in the domains of development of a child. Evidence: PCS. Frequency: 3/3. (PMID:11733564)
- Renal cortical cysts (HP:0000803): Cysts of the cortex of the kidney. Evidence: PCS. Frequency: 1/3. (PMID:11733564)
- Scaling skin (HP:0040189): Refers to the loss of the outer layer of the epidermis in large, scale-like flakes. Evidence: TAS. (OMIM:609180)
- Autosomal recessive inheritance (HP:0000007): A mode of inheritance that is observed for traits related to a gene encoded on one of the autosomes (i.e., the human chromosomes 1-22) in which a trait manifests in individuals with two pathogenic alleles, either homozygotes (two copies of the same mutant allele) or compound heterozygotes (whereby each copy of a gene has a distinct mutant allele). Evidence: PCS. (PMID:11733564)
- Erythroderma (HP:0001019): An inflammatory exfoliative dermatosis involving nearly all of the surface of the skin. Erythroderma develops suddenly. A patchy erythema may generalize and spread to affect most of the skin. Scaling may appear in 2-6 days and be accompanied by hot, red, dry skin, malaise, and fever. Evidence: TAS. (OMIM:609180)
- Optic atrophy (HP:0000648): Atrophy of the optic nerve. Optic atrophy results from the death of the retinal ganglion cell axons that comprise the optic nerve and manifesting as a pale optic nerve on fundoscopy. Evidence: TAS. (OMIM:609180)
- Hyperkeratosis (HP:0000962): Hyperkeratosis is a histopathological term defining a thickened stratum corneum and may be present in many different skin conditions, with many possible overlaps. Hyperkeratosis refers to the increased thickness of the stratum corneum, the outer layer of the skin. Hyperkeratosis is subclassified as orthokeratotic or parakeratotic. Orthokeratotic hyperkeratosis refers to the thickening of the keratin layer with preserved keratinocyte maturation, while parakeratotic hyperkeratosis shows retained nuclei as a sign of delayed maturation of keratinocytes. Evidence: TAS. (OMIM:609180)